- Visual loss (HP:0000572): Loss of visual acuity (implying that vision was better at a certain time point in life). Otherwise the term reduced visual acuity should be used (or a subclass of that). Evidence: PCS. Frequency: 1/1. (PMID:31778857)
- Peripheral axonal neuropathy (HP:0003477): An abnormality characterized by disruption of the normal functioning of peripheral axons. Evidence: PCS. Frequency: 1/1. (PMID:31778857)
- Premature ovarian insufficiency (HP:0008209): Amenorrhea due to loss of ovarian function before the age of 40. Primary ovarian insuficiency (POI) is a state of female hypergonadotropic hypogonadism. It can manifest as primary amenorrhea with onset before menarche or secondary amenorrhea. Evidence: PCS. Frequency: 1/1. (PMID:31778857)
- Gait disturbance (HP:0001288): The term gait disturbance can refer to any disruption of the ability to walk. Evidence: PCS. Frequency: 1/1. (PMID:31778857)
- Cerebral cortical atrophy (HP:0002120): Atrophy of the cortex of the cerebrum. Evidence: PCS. Frequency: 1/1. (PMID:31778857)
- Cerebellar atrophy (HP:0001272): Cerebellar atrophy is defined as a cerebellum with initially normal structures, in a posterior fossa with normal size, which displays enlarged fissures (interfolial spaces) in comparison to the foliae secondary to loss of tissue. Cerebellar atrophy implies irreversible loss of tissue and result from an ongoing progressive disease until a final stage is reached or a single injury, e.g. an intoxication or infectious event. Evidence: PCS. Frequency: 1/1. (PMID:31778857)
- Amenorrhea (HP:0000141): Absence of menses for an interval of time equivalent to a total of more than (or equal to) 3 previous cycles or 6 months. Evidence: PCS. Frequency: 1/1. (PMID:31778857)
- Ataxia (HP:0001251): Ataxia refers to impaired coordination of voluntary muscle movement. Cerebellar ataxia refers to ataxia due to dysfunction of the cerebellum. This causes a variety of elementary neurological deficits including asynergy (lack of coordination between muscles, limbs and joints), dysmetria (lack of ability to judge distances that can lead to under- or overshoot in grasping movements), and dysdiadochokinesia (inability to perform rapid movements requiring antagonizing muscle groups to be switched on and off repeatedly). Evidence: PCS. Frequency: 1/1. (PMID:31778857)
- Open angle glaucoma (HP:0012108): A type of glaucoma defined by an open, normal appearing anterior chamber angle and raised intraocular pressure,. Evidence: PCS. Frequency: 1/1. (PMID:31778857)
- Depression (HP:0000716): Frequently experiencing feelings of being down, miserable, and/or hopeless; struggling to recover from these moods; having a pessimistic outlook on the future; feeling a pervasive sense of shame; having a low self-worth; experiencing thoughts of suicide and engaging in suicidal behavior. Evidence: PCS. Frequency: 1/1. (PMID:31778857)
- Anxiety (HP:0000739): Intense feelings of nervousness, tension, or panic often arise in response to interpersonal stresses. There is worry about the negative effects of past unpleasant experiences and future negative possibilities. Individuals may feel fearful, apprehensive, or threatened by uncertainty, and they may also have fears of falling apart or losing control. Evidence: PCS. Frequency: 1/1. (PMID:31778857)
- Autosomal recessive inheritance (HP:0000007): A mode of inheritance that is observed for traits related to a gene encoded on one of the autosomes (i.e., the human chromosomes 1-22) in which a trait manifests in individuals with two pathogenic alleles, either homozygotes (two copies of the same mutant allele) or compound heterozygotes (whereby each copy of a gene has a distinct mutant allele). Evidence: TAS. (PMID:31778857)
- Optic atrophy (HP:0000648): Atrophy of the optic nerve. Optic atrophy results from the death of the retinal ganglion cell axons that comprise the optic nerve and manifesting as a pale optic nerve on fundoscopy. Evidence: PCS. Frequency: 1/1. (PMID:31778857)
- Headache (HP:0002315): Cephalgia, or pain sensed in various parts of the head, not confined to the area of distribution of any nerve. Evidence: PCS. Frequency: 1/1. (PMID:31778857)
These phenotypes are associated with the disease mitochondrial dna depletion syndrome 16B (neuroophthalmic type) (OMIM:619425).